- Psychosis (HP:0000709): A condition characterized by changes in personality and thought patterns, often accompanied by hallucinations and delusional beliefs, is known as psychosis. Evidence: TAS. (OMIM:277730)
- Confusion (HP:0001289): Lack of clarity and coherence of thought, perception, understanding, or action. Evidence: IEA. (OMIM:277730)
- Memory impairment (HP:0002354): An impairment of memory as manifested by a reduced ability to remember things such as dates and names, and increased forgetfulness. Evidence: TAS. (OMIM:277730)
- Polyneuropathy (HP:0001271): A generalized disorder of peripheral nerves. Evidence: IEA. (OMIM:277730)
- Ptosis (HP:0000508): The upper eyelid margin is positioned 3 mm or more lower than usual and covers the superior portion of the iris (objective); or, the upper lid margin obscures at least part of the pupil (subjective). Evidence: IEA. (OMIM:277730)
- Ataxia (HP:0001251): Ataxia refers to impaired coordination of voluntary muscle movement. Cerebellar ataxia refers to ataxia due to dysfunction of the cerebellum. This causes a variety of elementary neurological deficits including asynergy (lack of coordination between muscles, limbs and joints), dysmetria (lack of ability to judge distances that can lead to under- or overshoot in grasping movements), and dysdiadochokinesia (inability to perform rapid movements requiring antagonizing muscle groups to be switched on and off repeatedly). Evidence: IEA. (OMIM:277730)
- Ophthalmoplegia (HP:0000602): Paralysis of one or more extraocular muscles that are responsible for eye movements. Evidence: IEA. (OMIM:277730)
- Autosomal recessive inheritance (HP:0000007): A mode of inheritance that is observed for traits related to a gene encoded on one of the autosomes (i.e., the human chromosomes 1-22) in which a trait manifests in individuals with two pathogenic alleles, either homozygotes (two copies of the same mutant allele) or compound heterozygotes (whereby each copy of a gene has a distinct mutant allele). Evidence: IEA. (OMIM:277730)
- Delirium (HP:0031258): A state of sudden and severe confusion. Evidence: IEA. (OMIM:277730)
- Horizontal nystagmus (HP:0000666): Nystagmus consisting of horizontal to-and-fro eye movements. Evidence: IEA. (OMIM:277730)
- Coma (HP:0001259): The complete absence of wakefulness and consciousness, which is evident through a lack of response to any form of external stimuli. Evidence: TAS. (OMIM:277730)
These phenotypes are associated with the disease Wernicke-Korsakoff syndrome (OMIM:277730).